- Abnormal hair morphology (HP:0001595): An abnormality of the hair. Evidence: IEA. (OMIM:210750)
- Autosomal recessive inheritance (HP:0000007): A mode of inheritance that is observed for traits related to a gene encoded on one of the autosomes (i.e., the human chromosomes 1-22) in which a trait manifests in individuals with two pathogenic alleles, either homozygotes (two copies of the same mutant allele) or compound heterozygotes (whereby each copy of a gene has a distinct mutant allele). Evidence: IEA. (OMIM:210750)
These phenotypes are associated with the disease SKIN/HAIR/EYE PIGMENTATION, VARIATION IN, 6 (OMIM:210750).